- Horizontal supranuclear gaze palsy (HP:0007817): A supranuclear gaze palsy is an inability to look in a horizontal direction as a result of cerebral impairment. There is a loss of the voluntary aspect of eye movements, but, as the brainstem is still intact, all the reflex conjugate eye movements are normal. Evidence: PCS. (PMID:18412118)
- Seizure (HP:0001250): A seizure is an intermittent abnormality of nervous system physiology characterized by a transient occurrence of signs and/or symptoms due to abnormal excessive or synchronous neuronal activity in the brain. Evidence: PCS. Frequency: 5/29. (PMID:18412118)
- Sensorineural hearing impairment (HP:0000407): A type of hearing impairment in one or both ears related to an abnormal functionality of the cochlear nerve. Evidence: PCS. Frequency: 26/29. (PMID:18412118)
- Central hypoventilation (HP:0007110). Evidence: PCS. Frequency: 11/29. (PMID:18412118)
- Delayed gross motor development (HP:0002194): A type of motor delay characterized by a delay in acquiring the ability to control the large muscles of the body for walking, running, sitting, and crawling. Evidence: PCS. Frequency: 21/29. (PMID:18412118)
- Autosomal recessive inheritance (HP:0000007): A mode of inheritance that is observed for traits related to a gene encoded on one of the autosomes (i.e., the human chromosomes 1-22) in which a trait manifests in individuals with two pathogenic alleles, either homozygotes (two copies of the same mutant allele) or compound heterozygotes (whereby each copy of a gene has a distinct mutant allele). Evidence: PCS. (PMID:18412118)
- Duane anomaly (HP:0009921): A condition associated with a limitation of the horizontal ocular movement with retraction of the globe and narrowing of the palpebral fissure on adduction. Evidence: PCS. (PMID:18412118)
- Internal carotid artery hypoplasia (HP:0005290). Evidence: PCS. Frequency: 3/4. (PMID:18412118)
These phenotypes are associated with the disease human HOXA1 syndromes (OMIM:601536).